Phenotypes associated with the disease 14q11.2 microdeletion syndrome (ORPHA:261120):
- Narrow mouth (HP:0000160): Distance between the commissures of the mouth more than 2 SD below the mean. Alternatively, an apparently decreased width of the oral aperture (subjective). Evidence: TAS. Frequency: Frequent (HP:0040282). (ORPHA:261120)
- High palate (HP:0000218): Height of the palate more than 2 SD above the mean (objective) or palatal height at the level of the first permanent molar more than twice the height of the teeth (subjective). Evidence: TAS. Frequency: Frequent (HP:0040282). (ORPHA:261120)
- Everted lower lip vermilion (HP:0000232): An abnormal configuration of the lower lip such that it is turned outward i.e., everted, with the Inner aspect of the lower lip vermilion (normally opposing the teeth) being visible in a frontal view. Evidence: TAS. Frequency: Very frequent (HP:0040281). (ORPHA:261120)
- Epicanthus (HP:0000286): A fold of skin starting above the medial aspect of the upper eyelid and arching downward to cover, pass in front of and lateral to the medial canthus. Evidence: TAS. Frequency: Frequent (HP:0040282). (ORPHA:261120)
- Hypertelorism (HP:0000316): Interpupillary distance more than 2 SD above the mean (alternatively, the appearance of an increased interpupillary distance or widely spaced eyes). Evidence: TAS. Frequency: Very frequent (HP:0040281). (ORPHA:261120)
- Broad forehead (HP:0000337): Width of the forehead or distance between the frontotemporales is more than two standard deviations above the mean (objective); or apparently increased distance between the two sides of the forehead. Evidence: TAS. Frequency: Frequent (HP:0040282). (ORPHA:261120)
- Sloping forehead (HP:0000340): Inclination of the anterior surface of the forehead from the vertical more than two standard deviations above the mean (objective); or apparently excessive posterior sloping of the forehead in a lateral view. Evidence: TAS. Frequency: Frequent (HP:0040282). (ORPHA:261120)
- Long philtrum (HP:0000343): Distance between nasal base and midline upper lip vermilion border more than 2 SD above the mean. Alternatively, an apparently increased distance between nasal base and midline upper lip vermilion border. Evidence: TAS. Frequency: Very frequent (HP:0040281). (ORPHA:261120)
- Micrognathia (HP:0000347): Developmental hypoplasia of the mandible. Evidence: TAS. Frequency: Frequent (HP:0040282). (ORPHA:261120)
- Deeply set eye (HP:0000490): An eye that is more deeply recessed into the plane of the face than is typical. Evidence: TAS. Frequency: Frequent (HP:0040282). (ORPHA:261120)
- Blepharophimosis (HP:0000581): A fixed reduction in the vertical distance between the upper and lower eyelids with short palpebral fissures. Evidence: TAS. Frequency: Frequent (HP:0040282). (ORPHA:261120)
- Melanocytic nevus (HP:0000995): A oval and round, colored (usually medium-to dark brown, reddish brown, or flesh colored) lesion. Typically, a melanocytic nevus is less than 6 mm in diameter, but may be much smaller or larger. Evidence: TAS. Frequency: Frequent (HP:0040282). (ORPHA:261120)
- Mild intellectual disability (HP:0001256): Mild intellectual disability (ID) is defined as a type of ID characterized by mildly sub-average adaptive functioning and intellectual functioning, with an intelligence quotient (IQ) the range of 50-69. Evidence: TAS. Frequency: Very frequent (HP:0040281). (ORPHA:261120)
- Ventricular septal defect (HP:0001629): A hole between the two bottom chambers (ventricles) of the heart. The defect is centered around the most superior aspect of the ventricular septum. Evidence: TAS. Frequency: Frequent (HP:0040282). (ORPHA:261120)
- Patent ductus arteriosus (HP:0001643): In utero, the ductus arteriosus (DA) serves to divert ventricular output away from the lungs and toward the placenta by connecting the main pulmonary artery to the descending aorta. A patent ductus arteriosus (PDA) in the first 3 days of life is a physiologic shunt in healthy term and preterm newborn infants, and normally is substantially closed within about 24 hours after bith and completely closed after about three weeks. Failure of physiologcal closure is referred to a persistent or patent ductus arteriosus (PDA). Depending on the degree of left-to-right shunting, PDA can have clinical consequences. Evidence: TAS. Frequency: Frequent (HP:0040282). (ORPHA:261120)
- Toe syndactyly (HP:0001770): Webbing or fusion of the toes, involving soft parts only or including bone structure. Bony fusions are referred to as "bony" Syndactyly if the fusion occurs in a radio-ulnar axis. Fusions of bones of the toes in a proximo-distal axis are referred to as "Symphalangism". Evidence: TAS. Frequency: Frequent (HP:0040282). (ORPHA:261120)
- Toe clinodactyly (HP:0001863): Bending or curvature of a toe in the tibial direction (i.e., towards the big toe). Evidence: TAS. Frequency: Frequent (HP:0040282). (ORPHA:261120)
- Deep philtrum (HP:0002002): Accentuated, prominent philtral ridges giving rise to an exaggerated groove in the midline between the nasal base and upper vermillion border. Evidence: TAS. Frequency: Frequent (HP:0040282). (ORPHA:261120)
- Exaggerated cupid's bow (HP:0002263): More pronounced paramedian peaks and median notch of the Cupid's bow. Evidence: TAS. Frequency: Very frequent (HP:0040281). (ORPHA:261120)
- Highly arched eyebrow (HP:0002553): Increased height of the central portion of the eyebrow, forming a crescent, semicircular, or inverted U shape. Evidence: TAS. Frequency: Frequent (HP:0040282). (ORPHA:261120)
- Short nose (HP:0003196): Distance from nasion to subnasale more than two standard deviations below the mean, or alternatively, an apparently decreased length from the nasal root to the nasal tip. Evidence: TAS. Frequency: Very frequent (HP:0040281). (ORPHA:261120)
- Depressed nasal bridge (HP:0005280): Posterior positioning of the nasal root in relation to the overall facial profile for age. Evidence: TAS. Frequency: Very frequent (HP:0040281). (ORPHA:261120)
- Sparse lateral eyebrow (HP:0005338): Decreased density/number and/or decreased diameter of lateral eyebrow hairs. Evidence: TAS. Frequency: Frequent (HP:0040282). (ORPHA:261120)
- Severe global developmental delay (HP:0011344): A severe delay in the achievement of motor or mental milestones in the domains of development of a child. Evidence: TAS. Frequency: Very frequent (HP:0040281). (ORPHA:261120)
- Posteriorly rotated ears (HP:0000358): A type of abnormal location of the ears in which the position of the ears is characterized by posterior rotation (the superior part of the ears is rotated towards the back of the head, and the inferior part of the ears towards the front). Evidence: TAS. Frequency: Very frequent (HP:0040281). (ORPHA:261120)